Phenotypes associated with the disease Ebola hemorrhagic fever (ORPHA:319218):
- Fever (HP:0001945): Body temperature elevated above the normal range. Evidence: TAS. Frequency: Very frequent (HP:0040281). (ORPHA:319218)
- Diarrhea (HP:0002014): Abnormally increased frequency (usually defined as three or more) loose or watery bowel movements a day. Evidence: TAS. Frequency: Very frequent (HP:0040281). (ORPHA:319218)
- Increased circulating immunoglobulin concentration (HP:0010702): An increased level of gamma globulin (immunoglobulin) in the blood. Evidence: TAS. Frequency: Very frequent (HP:0040281). (ORPHA:319218)
- Viremia (HP:0020071): The presence of virus in the blood. Evidence: TAS. Frequency: Very frequent (HP:0040281). (ORPHA:319218)
- Chest pain (HP:0100749): An unpleasant sensation characterized by physical discomfort (such as pricking, throbbing, or aching) localized to the chest. Evidence: TAS. Frequency: Very frequent (HP:0040281). (ORPHA:319218)
- Decreased total leukocyte count (HP:0001882): An abnormal decreased number of leukocytes in the blood. Evidence: TAS. Frequency: Frequent (HP:0040282). (ORPHA:319218)
- Decreased total lymphocyte count (HP:0001888): A reduced number of lymphocytes in the blood. Evidence: TAS. Frequency: Frequent (HP:0040282). (ORPHA:319218)
- Abnormal bleeding (HP:0001892): An abnormal susceptibility to bleeding, often referred to as a bleeding diathesis. A bleeding diathesis may be related to vascular, platelet and coagulation defects. Evidence: TAS. Frequency: Frequent (HP:0040282). (ORPHA:319218)
- Vomiting (HP:0002013): Forceful ejection of the contents of the stomach through the mouth by means of a series of involuntary spasmic contractions. Evidence: TAS. Frequency: Frequent (HP:0040282). (ORPHA:319218)
- Dysphagia (HP:0002015): Difficulty in swallowing. Evidence: TAS. Frequency: Frequent (HP:0040282). (ORPHA:319218)
- Nausea (HP:0002018): A sensation of unease in the stomach together with an urge to vomit. Evidence: TAS. Frequency: Frequent (HP:0040282). (ORPHA:319218)
- Abdominal pain (HP:0002027): An unpleasant sensation characterized by physical discomfort (such as pricking, throbbing, or aching) and perceived to originate in the abdomen. Evidence: TAS. Frequency: Frequent (HP:0040282). (ORPHA:319218)
- Gastrointestinal hemorrhage (HP:0002239): Hemorrhage affecting the gastrointestinal tract. Evidence: TAS. Frequency: Frequent (HP:0040282). (ORPHA:319218)
- Melena (HP:0002249): The passage of blackish, tarry feces associated with gastrointestinal hemorrhage. Melena occurs if the blood remains in the colon long enough for it to be broken down by colonic bacteria. One degradation product, hematin, imbues the stool with a blackish color. Thus, melena generally occurs with bleeding from the upper gastrointestinal tract (e.g., stomach ulcers or duodenal ulcers), since the blood usually remains in the gut for a longer period of time than with lower gastrointestinal bleeding. Evidence: TAS. Frequency: Frequent (HP:0040282). (ORPHA:319218)
- Headache (HP:0002315): Cephalgia, or pain sensed in various parts of the head, not confined to the area of distribution of any nerve. Evidence: TAS. Frequency: Frequent (HP:0040282). (ORPHA:319218)
- Poor appetite (HP:0004396): A reduced desire to eat. Evidence: TAS. Frequency: Frequent (HP:0040282). (ORPHA:319218)
- Hepatitis (HP:0012115): Inflammation of the liver. Evidence: TAS. Frequency: Frequent (HP:0040282). (ORPHA:319218)
- Cough (HP:0012735): A sudden, audible expulsion of air from the lungs through a partially closed glottis, preceded by inhalation. Evidence: TAS. Frequency: Frequent (HP:0040282). (ORPHA:319218)
- Chills (HP:0025143): A sudden sensation of feeling cold. Evidence: TAS. Frequency: Frequent (HP:0040282). (ORPHA:319218)
- Pharyngitis (HP:0025439): Inflammation (due to infection or irritation) of the pharynx. Evidence: TAS. Frequency: Frequent (HP:0040282). (ORPHA:319218)
- Maculopapular exanthema (HP:0040186): A skin rash that is characterized by diffuse cutaneous erythema with areas of skin elevation. It may evolve to vesicles or papules as part of a more severe clinical entity. Different degrees of angioedema with involvement of subcutaneous tissue may also appear. Evidence: TAS. Frequency: Frequent (HP:0040282). (ORPHA:319218)
- Sepsis (HP:0100806): Sepsis is defined as life-threatening organ dysfunction caused by a dysregulated host response to infection. Evidence: TAS. Frequency: Frequent (HP:0040282). (ORPHA:319218)
- Lethargy (HP:0001254): A state of fatigue, either physical or mental slowness and sluggishness, with difficulties in initiating or performing simple tasks. Distinguished from apathy which implies indifference and a lack of desire or interest in the task. A person with lethargy may have the desire, but not the energy to engage in personal or socially relevant tasks. Evidence: TAS. Frequency: Occasional (HP:0040283). (ORPHA:319218)
- Acute pancreatitis (HP:0001735): A acute form of pancreatitis. Evidence: TAS. Frequency: Occasional (HP:0040283). (ORPHA:319218)
- Thrombocytopenia (HP:0001873): A reduction in the number of circulating thrombocytes. Evidence: TAS. Frequency: Occasional (HP:0040283). (ORPHA:319218)
- Dyspnea (HP:0002094): Difficult or labored breathing. Dyspnea is a subjective feeling only the patient can rate, e.g., on a Borg scale. Evidence: TAS. Frequency: Occasional (HP:0040283). (ORPHA:319218)
- Arthralgia (HP:0002829): Joint pain. Evidence: TAS. Frequency: Occasional (HP:0040283). (ORPHA:319218)
- Disseminated intravascular coagulation (HP:0005521): Disseminated intravascular coagulation is characterized by the widespread activation of coagulation, which results in the intravascular formation of fibrin and ultimately thrombotic occlusion of small and midsize vessels. Evidence: TAS. Frequency: Occasional (HP:0040283). (ORPHA:319218)
- Recurrent singultus (HP:0100247): A contraction of the diaphragm that repeats several times per minute. In humans, the abrupt rush of air into the lungs causes the epiglottis to close, creating a hic sound. Also known as synchronous diaphragmatic flutter (SDF), or singultus, from the Latin singult, the act of catching one's breath while sobbing. The hiccup is an involuntary action involving a reflex arc. Evidence: TAS. Frequency: Occasional (HP:0040283). (ORPHA:319218)